Phenotypes associated with the disease Ectodermal dysplasia, trichoodontoonychial type (ORPHA:1818):
- Sparse hair (HP:0008070): Reduced density of hairs. Evidence: TAS. Frequency: Very frequent (HP:0040281). (ORPHA:1818)
- Abnormal dental morphology (HP:0006482): An abnormality of the morphology of the tooth. Evidence: TAS. Frequency: Very frequent (HP:0040281). (ORPHA:1818)
- Irregular hyperpigmentation of back (HP:0007521). Evidence: TAS. Frequency: Very frequent (HP:0040281). (ORPHA:1818)
- Abnormal toenail morphology (HP:0008388): An anomaly of the toenail. Evidence: TAS. Frequency: Very frequent (HP:0040281). (ORPHA:1818)
- Lipoatrophy (HP:0100578): Localized loss of fat tissue. Evidence: TAS. Frequency: Very frequent (HP:0040281). (ORPHA:1818)
- Abnormal eyelash morphology (HP:0000499): An abnormality of the eyelashes. Evidence: TAS. Frequency: Frequent (HP:0040282). (ORPHA:1818)
- Melanocytic nevus (HP:0000995): A oval and round, colored (usually medium-to dark brown, reddish brown, or flesh colored) lesion. Typically, a melanocytic nevus is less than 6 mm in diameter, but may be much smaller or larger. Evidence: TAS. Frequency: Frequent (HP:0040282). (ORPHA:1818)
- Aplasia/Hypoplasia of the nipples (HP:0006709). Evidence: TAS. Frequency: Frequent (HP:0040282). (ORPHA:1818)
- Aplasia/Hypoplasia of the eyebrow (HP:0100840): Absence or underdevelopment of the eyebrow. Evidence: TAS. Frequency: Frequent (HP:0040282). (ORPHA:1818)
- Abnormality of the nose (HP:0000366): An abnormality of the nose. Evidence: TAS. Frequency: Very frequent (HP:0040281). (ORPHA:1818)
- Hypodontia (HP:0000668): The absence of five or less teeth from the normal series by a failure to develop. Evidence: TAS. Frequency: Very frequent (HP:0040281). (ORPHA:1818)
- Sparse body hair (HP:0002231): Sparseness of the body hair. Evidence: TAS. Frequency: Very frequent (HP:0040281). (ORPHA:1818)